- Progressive (HP:0003676): Applies to a disease manifestation that increases in scope or severity over the course of time, i.e., that worsens with age. Evidence: PCS. (PMID:27657680)
- Abnormal vestibular function (HP:0001751): An abnormality of the functioning of the vestibular apparatus. Evidence: PCS. Frequency: 0/11. (PMID:27657680)
- Sensorineural hearing impairment (HP:0000407): A type of hearing impairment in one or both ears related to an abnormal functionality of the cochlear nerve. Evidence: PCS. Frequency: 11/11. Onset: Young adult onset (HP:0011462). (PMID:27657680)
- Autosomal dominant inheritance (HP:0000006): A mode of inheritance that is observed for traits related to a gene encoded on one of the autosomes (i.e., the human chromosomes 1-22) in which a trait manifests in heterozygotes. In the context of medical genetics, an autosomal dominant disorder is caused when a single copy of the mutant allele is present. Males and females are affected equally, and can both transmit the disorder with a risk of 50% for each child of inheriting the mutant allele. Evidence: PCS. (PMID:27657680)
These phenotypes are associated with the disease hearing loss, autosomal dominant 71 (OMIM:617605).